Phenotypes associated with the disease X-linked intellectual disability-global development delay-facial dysmorphism-sacral caudal remnant syndrome (ORPHA:480907):
- Low-set ears (HP:0000369): Upper insertion of the ear to the scalp below an imaginary horizontal line drawn between the inner canthi of the eye and extending posteriorly to the ear. Evidence: TAS. Frequency: Very frequent (HP:0040281). (ORPHA:480907)
- Protruding ear (HP:0000411): Angle formed by the plane of the ear and the mastoid bone greater than the 97th centile for age (objective); or, outer edge of the helix more than 2 cm from the mastoid at the point of maximum distance (objective). Evidence: TAS. Frequency: Very frequent (HP:0040281). (ORPHA:480907)
- Delayed speech and language development (HP:0000750): A degree of language development that is significantly below the norm for a child of a specified age. Evidence: TAS. Frequency: Very frequent (HP:0040281). (ORPHA:480907)
- Intellectual disability (HP:0001249): The term intellectual disability or intellectual developmental disorder is used to describe significantly sub-average intellectual and adaptive functioning based on clinical assessment and as measured by individually administered, appropriately normed, standardized and validated tests of intellectual functioning and adaptive behavior, with onset during the developmental period from infancy through adolescence. Evidence: TAS. Frequency: Very frequent (HP:0040281). (ORPHA:480907)
- Global developmental delay (HP:0001263): A delay in the achievement of motor or mental milestones in the domains of development of a child, including motor skills, speech and language, cognitive skills, and social and emotional skills. This term should only be used to describe children younger than five years of age. Evidence: TAS. Frequency: Very frequent (HP:0040281). (ORPHA:480907)
- Generalized hypotonia (HP:0001290): Generalized muscular hypotonia (abnormally low muscle tone). Evidence: TAS. Frequency: Very frequent (HP:0040281). (ORPHA:480907)
- Abnormal facial shape (HP:0001999): An abnormal morphology (form) of the face or its components. Evidence: TAS. Frequency: Very frequent (HP:0040281). (ORPHA:480907)
- Hypoplasia of the corpus callosum (HP:0002079): Underdevelopment of the corpus callosum. Evidence: TAS. Frequency: Very frequent (HP:0040281). (ORPHA:480907)
- Delayed gross motor development (HP:0002194): A type of motor delay characterized by a delay in acquiring the ability to control the large muscles of the body for walking, running, sitting, and crawling. Evidence: TAS. Frequency: Very frequent (HP:0040281). (ORPHA:480907)
- Severe expressive language delay (HP:0006863): A severe delay in the acquisition of the ability to use language to communicate needs, wishes, or thoughts. Evidence: TAS. Frequency: Very frequent (HP:0040281). (ORPHA:480907)
- Abnormal sacral segmentation (HP:0008468): An abnormality related to a defect of vertebral separation of sacral vertebrae during development. Evidence: TAS. Frequency: Very frequent (HP:0040281). (ORPHA:480907)
- Prominent protruding coccyx (HP:0008472). Evidence: TAS. Frequency: Very frequent (HP:0040281). (ORPHA:480907)
- Postnatal growth retardation (HP:0008897): Slow or limited growth after birth. Evidence: TAS. Frequency: Very frequent (HP:0040281). (ORPHA:480907)
- High palate (HP:0000218): Height of the palate more than 2 SD above the mean (objective) or palatal height at the level of the first permanent molar more than twice the height of the teeth (subjective). Evidence: TAS. Frequency: Frequent (HP:0040282). (ORPHA:480907)
- Long face (HP:0000276): Facial height (length) is more than 2 standard deviations above the mean (objective); or, an apparent increase in the height (length) of the face (subjective). Evidence: TAS. Frequency: Frequent (HP:0040282). (ORPHA:480907)
- Pointed chin (HP:0000307): A marked tapering of the lower face to the chin. Evidence: TAS. Frequency: Frequent (HP:0040282). (ORPHA:480907)
- Prominent supraorbital ridges (HP:0000336): Greater than average forward and/or lateral protrusion of the supraorbital portion of the frontal bones. Evidence: TAS. Frequency: Frequent (HP:0040282). (ORPHA:480907)
- Long philtrum (HP:0000343): Distance between nasal base and midline upper lip vermilion border more than 2 SD above the mean. Alternatively, an apparently increased distance between nasal base and midline upper lip vermilion border. Evidence: TAS. Frequency: Frequent (HP:0040282). (ORPHA:480907)
- Hearing impairment (HP:0000365): A decreased magnitude of the sensory perception of sound. Evidence: TAS. Frequency: Frequent (HP:0040282). (ORPHA:480907)
- Chronic otitis media (HP:0000389): Chronic otitis media refers to fluid, swelling, or infection of the middle ear that does not heal and may cause permanent damage to the ear. Evidence: TAS. Frequency: Frequent (HP:0040282). (ORPHA:480907)
- Anteverted nares (HP:0000463): Anteriorly-facing nostrils viewed with the head in the Frankfurt horizontal and the eyes of the observer level with the eyes of the subject. This gives the appearance of an upturned nose (upturned nasal tip). Evidence: TAS. Frequency: Frequent (HP:0040282). (ORPHA:480907)
- Strabismus (HP:0000486): A misalignment of the eyes so that the visual axes deviate from bifoveal fixation. The classification of strabismus may be based on a number of features including the relative position of the eyes, whether the deviation is latent or manifest, intermittent or constant, concomitant or otherwise and according to the age of onset and the relevance of any associated refractive error. Evidence: TAS. Frequency: Frequent (HP:0040282). (ORPHA:480907)
- Downslanted palpebral fissures (HP:0000494): The palpebral fissure inclination is more than two standard deviations below the mean. Evidence: TAS. Frequency: Frequent (HP:0040282). (ORPHA:480907)
- Autistic behavior (HP:0000729): Persistent deficits in social interaction and communication and interaction as well as a markedly restricted repertoire of activity and interest as well as repetitive patterns of behavior. Evidence: TAS. Frequency: Frequent (HP:0040282). (ORPHA:480907)
- Joint hypermobility (HP:0001382): The capability that a joint (or a group of joints) has to move, passively and/or actively, beyond normal limits along physiological axes. Evidence: TAS. Frequency: Frequent (HP:0040282). (ORPHA:480907)
- Moderate intellectual disability (HP:0002342): Moderate intellectual disability (ID) is defined as a type of ID characterized by moderately sub-average adaptive functioning and intellectual functioning, with an intelligence quotient (IQ) the range of 35-49. Evidence: TAS. Frequency: Frequent (HP:0040282). (ORPHA:480907)
- Oral-pharyngeal dysphagia (HP:0200136). Evidence: TAS. Frequency: Frequent (HP:0040282). (ORPHA:480907)
- Thin upper lip vermilion (HP:0000219): Height of the vermilion of the upper lip in the midline more than 2 SD below the mean. Alternatively, an apparently reduced height of the vermilion of the upper lip in the frontal view (subjective). Evidence: TAS. Frequency: Occasional (HP:0040283). (ORPHA:480907)
- Microcephaly (HP:0000252): Head circumference below 2 standard deviations below the mean for age and gender. Evidence: TAS. Frequency: Occasional (HP:0040283). (ORPHA:480907)
- Epicanthus (HP:0000286): A fold of skin starting above the medial aspect of the upper eyelid and arching downward to cover, pass in front of and lateral to the medial canthus. Evidence: TAS. Frequency: Occasional (HP:0040283). (ORPHA:480907)
- Micrognathia (HP:0000347): Developmental hypoplasia of the mandible. Evidence: TAS. Frequency: Occasional (HP:0040283). (ORPHA:480907)
- Bulbous nose (HP:0000414): Increased volume and globular shape of the anteroinferior aspect of the nose. Evidence: TAS. Frequency: Occasional (HP:0040283). (ORPHA:480907)
- Broad nasal tip (HP:0000455): Increase in width of the nasal tip. Evidence: TAS. Frequency: Occasional (HP:0040283). (ORPHA:480907)
- Deeply set eye (HP:0000490): An eye that is more deeply recessed into the plane of the face than is typical. Evidence: TAS. Frequency: Occasional (HP:0040283). (ORPHA:480907)
- Long eyelashes (HP:0000527): Mid upper eyelash length >10 mm or increased length of the eyelashes (subjective). Evidence: TAS. Frequency: Occasional (HP:0040283). (ORPHA:480907)
- Thick eyebrow (HP:0000574): Increased density/number and/or increased diameter of eyebrow hairs. Evidence: TAS. Frequency: Occasional (HP:0040283). (ORPHA:480907)
- Synophrys (HP:0000664): Meeting of the medial eyebrows in the midline. Evidence: TAS. Frequency: Occasional (HP:0040283). (ORPHA:480907)
- Seizure (HP:0001250): A seizure is an intermittent abnormality of nervous system physiology characterized by a transient occurrence of signs and/or symptoms due to abnormal excessive or synchronous neuronal activity in the brain. Evidence: TAS. Frequency: Occasional (HP:0040283). (ORPHA:480907)
- Spastic diplegia (HP:0001264): Spasticity (neuromuscular hypertonia) primarily in the muscles of the legs, hips, and pelvis. Evidence: TAS. Frequency: Occasional (HP:0040283). (ORPHA:480907)
- Dystonia (HP:0001332): An abnormally increased muscular tone that causes fixed abnormal postures. There is a slow, intermittent twisting motion that leads to exaggerated turning and posture of the extremities and trunk. Evidence: TAS. Frequency: Occasional (HP:0040283). (ORPHA:480907)
- Tremor (HP:0001337): An unintentional, oscillating to-and-fro muscle movement about a joint axis. Evidence: TAS. Frequency: Occasional (HP:0040283). (ORPHA:480907)
- Obesity (HP:0001513): Accumulation of substantial excess body fat. Evidence: TAS. Frequency: Occasional (HP:0040283). (ORPHA:480907)
- Lower limb hyperreflexia (HP:0002395): Increased intensity of the a reflex in the leg. Evidence: TAS. Frequency: Occasional (HP:0040283). (ORPHA:480907)
- Depressed nasal bridge (HP:0005280): Posterior positioning of the nasal root in relation to the overall facial profile for age. Evidence: TAS. Frequency: Occasional (HP:0040283). (ORPHA:480907)
- Lipoma (HP:0012032): Benign neoplasia derived from lipoblasts or lipocytes of white or brown fat. May be angiomatous or hibernomatous. Evidence: TAS. Frequency: Occasional (HP:0040283). (ORPHA:480907)